Phenotypes associated with the disease pruritus, hereditary localized (OMIM:177100):
- Adult onset (HP:0003581): Onset of disease manifestations in adulthood, defined here as at the age of 16 years or later. Evidence: IEA. (OMIM:177100)
- Pruritus (HP:0000989): Pruritus is an itch or a sensation that makes a person want to scratch. This term refers to an abnormally increased disposition to experience pruritus. Evidence: IEA. (OMIM:177100)
- X-linked dominant inheritance (HP:0001423): A mode of inheritance that is observed for dominant traits related to a gene encoded on the X chromosome. In the context of medical genetics, X-linked dominant disorders tend to manifest very severely in affected males. The severity of manifestation in females may depend on the degree of skewed X inactivation. Evidence: TAS. (OMIM:177100)
- Autosomal dominant inheritance (HP:0000006): A mode of inheritance that is observed for traits related to a gene encoded on one of the autosomes (i.e., the human chromosomes 1-22) in which a trait manifests in heterozygotes. In the context of medical genetics, an autosomal dominant disorder is caused when a single copy of the mutant allele is present. Males and females are affected equally, and can both transmit the disorder with a risk of 50% for each child of inheriting the mutant allele. Evidence: TAS. (OMIM:177100)